- Epiphora (HP:0009926): Abnormally increased lacrimation, that is, excessive tearing (watering eye). Evidence: PCS. (PMID:16199541)
- Spicular pigmentation of the retina (HP:0007737): Pigment migration into the retina in a bone-spicule configuration (resembling the nucleated cells within the lacuna of bone). Evidence: PCS. (PMID:16199541)
- Nyctalopia (HP:0000662): Inability to see well at night or in poor light. Evidence: PCS. (PMID:16199541)
- Progressive visual loss (HP:0000529): A reduction of previously attained ability to see. Evidence: PCS. (PMID:16199541)
- Macular degeneration (HP:0000608): A nonspecific term denoting degeneration of the retinal pigment epithelium and/or retinal photoreceptor cells of the macula lutea. Evidence: PCS. (PMID:16199541)
- Photophobia (HP:0000613): Excessive sensitivity to light with the sensation of discomfort or pain in the eyes due to exposure to bright light. Evidence: PCS. (PMID:16199541)
- Autosomal recessive inheritance (HP:0000007): A mode of inheritance that is observed for traits related to a gene encoded on one of the autosomes (i.e., the human chromosomes 1-22) in which a trait manifests in individuals with two pathogenic alleles, either homozygotes (two copies of the same mutant allele) or compound heterozygotes (whereby each copy of a gene has a distinct mutant allele). Evidence: PCS. (PMID:16199541)
- Peripheral visual field loss (HP:0007994): Loss of peripheral vision with retention of central vision, resulting in a constricted circular tunnel-like field of vision. Evidence: PCS. (PMID:16199541)
- Rod-cone dystrophy (HP:0000510): An inherited retinal disease subtype in which the rod photoreceptors appear to be more severely affected than the cone photoreceptors. Typical presentation is with nyctalopia (due to rod dysfunction) followed by loss of mid-peripheral field of vision, which gradually extends and leaves many patients with a small central island of vision due to the preservation of macular cones. Evidence: PCS. (PMID:16199541)
- Attenuation of retinal blood vessels (HP:0007843): Narrowing of the retinal blood vessels, both arterioles and venules. Evidence: PCS. (PMID:16199541)
These phenotypes are associated with the disease cone-rod dystrophy 10 (OMIM:610283).